- Hyporeflexia (HP:0001265): Reduction of neurologic reflexes such as the knee-jerk reaction. Evidence: IEA. (OMIM:136600)
- Sensorineural hearing impairment (HP:0000407): A type of hearing impairment in one or both ears related to an abnormal functionality of the cochlear nerve. Evidence: IEA. (OMIM:136600)
- Ataxia (HP:0001251): Ataxia refers to impaired coordination of voluntary muscle movement. Cerebellar ataxia refers to ataxia due to dysfunction of the cerebellum. This causes a variety of elementary neurological deficits including asynergy (lack of coordination between muscles, limbs and joints), dysmetria (lack of ability to judge distances that can lead to under- or overshoot in grasping movements), and dysdiadochokinesia (inability to perform rapid movements requiring antagonizing muscle groups to be switched on and off repeatedly). Evidence: IEA. (OMIM:136600)
- Optic atrophy (HP:0000648): Atrophy of the optic nerve. Optic atrophy results from the death of the retinal ganglion cell axons that comprise the optic nerve and manifesting as a pale optic nerve on fundoscopy. Evidence: IEA. (OMIM:136600)
- Autosomal dominant inheritance (HP:0000006): A mode of inheritance that is observed for traits related to a gene encoded on one of the autosomes (i.e., the human chromosomes 1-22) in which a trait manifests in heterozygotes. In the context of medical genetics, an autosomal dominant disorder is caused when a single copy of the mutant allele is present. Males and females are affected equally, and can both transmit the disorder with a risk of 50% for each child of inheriting the mutant allele. Evidence: IEA. (OMIM:136600)
These phenotypes are associated with the disease Friedreich ataxia, so-called, with optic atrophy and sensorineural deafness (OMIM:136600).